Phenotypes associated with the disease spermatogenic failure 41 (OMIM:618670):
- Male infertility (HP:0003251). Evidence: PCS. Frequency: 1/1. (PMID:31621862)
- Tapered sperm head (HP:0032562): Sperm with cigar-shaped heads that gradually dimish in diameter (taper). Evidence: PCS. Frequency: 1/1. (PMID:31621862)
- Autosomal recessive inheritance (HP:0000007): A mode of inheritance that is observed for traits related to a gene encoded on one of the autosomes (i.e., the human chromosomes 1-22) in which a trait manifests in individuals with two pathogenic alleles, either homozygotes (two copies of the same mutant allele) or compound heterozygotes (whereby each copy of a gene has a distinct mutant allele). Evidence: PCS. (PMID:31621862)
- Immotile sperm (HP:0012208): A lack of mobility of ejaculated sperm. Evidence: PCS. Frequency: 1/1. (PMID:31621862)
- Oligozoospermia (HP:0000798): Reduced count of spermatozoa in the semen, defined as a sperm count below 20 million per milliliter semen. Evidence: PCS. Frequency: 1/1. (PMID:31621862)
- Short sperm flagella (HP:0032559): Sperm cells with abnormally short flagella. Evidence: PCS. Frequency: 1/1. (PMID:31621862)